Phenotypes associated with the disease 16p11.2p12.2 microdeletion syndrome (ORPHA:261211):
- Open mouth (HP:0000194): A facial appearance characterized by a permanently or nearly permanently opened mouth. Evidence: TAS. Frequency: Frequent (HP:0040282). (ORPHA:261211)
- Orofacial cleft (HP:0000202): The presence of a cleft (gap, opening, or groove) in the oral cavity, including cleft of the upper lip and/or cleft of the palate. Cleft of the upper lip is visible as a groove or fissure in the lip, most frequently due to a congenital failure of the maxillary and median nasal processes to fuse. Cleft palate is characterized by a grooved depression or fissure in the roof of the mouth, most often resulting from a congenital failure of the palate to fuse properly. Clefts of the lip and palate can occur individually or together. It is preferable to code each defect separately. Evidence: TAS. Frequency: Occasional (HP:0040283). (ORPHA:261211)
- Long face (HP:0000276): Facial height (length) is more than 2 standard deviations above the mean (objective); or, an apparent increase in the height (length) of the face (subjective). Evidence: TAS. Frequency: Occasional (HP:0040283). (ORPHA:261211)
- Epicanthus (HP:0000286): A fold of skin starting above the medial aspect of the upper eyelid and arching downward to cover, pass in front of and lateral to the medial canthus. Evidence: TAS. Frequency: Frequent (HP:0040282). (ORPHA:261211)
- Microretrognathia (HP:0000308): A form of developmental hypoplasia of the mandible in which the mandible is mislocalised posteriorly. Evidence: TAS. Frequency: Frequent (HP:0040282). (ORPHA:261211)
- High forehead (HP:0000348): An abnormally increased height of the forehead. Evidence: TAS. Frequency: Occasional (HP:0040283). (ORPHA:261211)
- Hearing impairment (HP:0000365): A decreased magnitude of the sensory perception of sound. Evidence: TAS. Frequency: Occasional (HP:0040283). (ORPHA:261211)
- Low-set ears (HP:0000369): Upper insertion of the ear to the scalp below an imaginary horizontal line drawn between the inner canthi of the eye and extending posteriorly to the ear. Evidence: TAS. Frequency: Frequent (HP:0040282). (ORPHA:261211)
- Abnormal pinna morphology (HP:0000377): An abnormality of the pinna, which is also referred to as the auricle or external ear. Evidence: TAS. Frequency: Frequent (HP:0040282). (ORPHA:261211)
- Chronic otitis media (HP:0000389): Chronic otitis media refers to fluid, swelling, or infection of the middle ear that does not heal and may cause permanent damage to the ear. Evidence: TAS. Frequency: Very frequent (HP:0040281). (ORPHA:261211)
- Bulbous nose (HP:0000414): Increased volume and globular shape of the anteroinferior aspect of the nose. Evidence: TAS. Frequency: Occasional (HP:0040283). (ORPHA:261211)
- Anteverted nares (HP:0000463): Anteriorly-facing nostrils viewed with the head in the Frankfurt horizontal and the eyes of the observer level with the eyes of the subject. This gives the appearance of an upturned nose (upturned nasal tip). Evidence: TAS. Frequency: Occasional (HP:0040283). (ORPHA:261211)
- Strabismus (HP:0000486): A misalignment of the eyes so that the visual axes deviate from bifoveal fixation. The classification of strabismus may be based on a number of features including the relative position of the eyes, whether the deviation is latent or manifest, intermittent or constant, concomitant or otherwise and according to the age of onset and the relevance of any associated refractive error. Evidence: TAS. Frequency: Occasional (HP:0040283). (ORPHA:261211)
- Deeply set eye (HP:0000490): An eye that is more deeply recessed into the plane of the face than is typical. Evidence: TAS. Frequency: Frequent (HP:0040282). (ORPHA:261211)
- Downslanted palpebral fissures (HP:0000494): The palpebral fissure inclination is more than two standard deviations below the mean. Evidence: TAS. Frequency: Very frequent (HP:0040281). (ORPHA:261211)
- Blepharophimosis (HP:0000581): A fixed reduction in the vertical distance between the upper and lower eyelids with short palpebral fissures. Evidence: TAS. Frequency: Frequent (HP:0040282). (ORPHA:261211)
- Hypotelorism (HP:0000601): Interpupillary distance less than 2 SD below the mean (alternatively, the appearance of an decreased interpupillary distance or closely spaced eyes). Evidence: TAS. Frequency: Occasional (HP:0040283). (ORPHA:261211)
- Delayed speech and language development (HP:0000750): A degree of language development that is significantly below the norm for a child of a specified age. Evidence: TAS. Frequency: Frequent (HP:0040282). (ORPHA:261211)
- Hyperactivity (HP:0000752): Hyperactivity is a condition characterized by constant and unusually high levels of activity, even in situations where it is deemed inappropriate. Evidence: TAS. Frequency: Frequent (HP:0040282). (ORPHA:261211)
- Hypotonia (HP:0001252): Hypotonia is an abnormally low muscle tone (the amount of tension or resistance to movement in a muscle). Even when relaxed, muscles have a continuous and passive partial contraction which provides some resistance to passive stretching. Hypotonia thus manifests as diminished resistance to passive stretching. Hypotonia is not the same as muscle weakness, although the two conditions can co-exist. Evidence: TAS. Frequency: Frequent (HP:0040282). (ORPHA:261211)
- Global developmental delay (HP:0001263): A delay in the achievement of motor or mental milestones in the domains of development of a child, including motor skills, speech and language, cognitive skills, and social and emotional skills. This term should only be used to describe children younger than five years of age. Evidence: TAS. Frequency: Very frequent (HP:0040281). (ORPHA:261211)
- Intrauterine growth retardation (HP:0001511): An abnormal restriction of fetal growth with fetal weight below the tenth percentile for gestational age. Evidence: TAS. Frequency: Very frequent (HP:0040281). (ORPHA:261211)
- Toe syndactyly (HP:0001770): Webbing or fusion of the toes, involving soft parts only or including bone structure. Bony fusions are referred to as "bony" Syndactyly if the fusion occurs in a radio-ulnar axis. Fusions of bones of the toes in a proximo-distal axis are referred to as "Symphalangism". Evidence: TAS. Frequency: Frequent (HP:0040282). (ORPHA:261211)
- Frontal bossing (HP:0002007): Bilateral bulging of the lateral frontal bone prominences with relative sparing of the midline. Evidence: TAS. Frequency: Frequent (HP:0040282). (ORPHA:261211)
- Gastroesophageal reflux (HP:0002020): A condition in which the stomach contents leak backwards from the stomach into the esophagus through the lower esophageal sphincter. Evidence: TAS. Frequency: Very frequent (HP:0040281). (ORPHA:261211)
- Moderate intellectual disability (HP:0002342): Moderate intellectual disability (ID) is defined as a type of ID characterized by moderately sub-average adaptive functioning and intellectual functioning, with an intelligence quotient (IQ) the range of 35-49. Evidence: TAS. Frequency: Very frequent (HP:0040281). (ORPHA:261211)
- Sleep disturbance (HP:0002360): An abnormal pattern in the quality, quantity, or characteristics of sleep. Evidence: TAS. Frequency: Occasional (HP:0040283). (ORPHA:261211)
- Long nose (HP:0003189): Distance from nasion to subnasale more than two standard deviations above the mean, or alternatively, an apparently increased length from the nasal root to the nasal base. Evidence: TAS. Frequency: Occasional (HP:0040283). (ORPHA:261211)
- Short nose (HP:0003196): Distance from nasion to subnasale more than two standard deviations below the mean, or alternatively, an apparently decreased length from the nasal root to the nasal tip. Evidence: TAS. Frequency: Occasional (HP:0040283). (ORPHA:261211)
- Short palm (HP:0004279): Short palm. Evidence: TAS. Frequency: Occasional (HP:0040283). (ORPHA:261211)
- Short stature (HP:0004322): A height below that which is expected according to age and gender norms. Although there is no universally accepted definition of short stature, many refer to "short stature" as height more than 2 standard deviations below the mean for age and gender (or below the 3rd percentile for age and gender dependent norms). Evidence: TAS. Frequency: Frequent (HP:0040282). (ORPHA:261211)
- Tricuspid regurgitation (HP:0005180): Failure of the tricuspid valve to close sufficiently upon contraction of the right ventricle, causing blood to regurgitate (flow backward) into the right atrium. Evidence: TAS. Frequency: Occasional (HP:0040283). (ORPHA:261211)
- Absent nasal bridge (HP:0005285). Evidence: TAS. Frequency: Occasional (HP:0040283). (ORPHA:261211)
- Impaired pain sensation (HP:0007328): Reduced ability to perceive painful stimuli. Evidence: TAS. Frequency: Frequent (HP:0040282). (ORPHA:261211)
- Multiple cafe-au-lait spots (HP:0007565): The presence of six or more cafe-au-lait spots. Evidence: TAS. Frequency: Frequent (HP:0040282). (ORPHA:261211)
- Bilateral single transverse palmar creases (HP:0007598): The distal and proximal transverse palmar creases are merged into a single transverse palmar crease on both hands. Evidence: TAS. Frequency: Frequent (HP:0040282). (ORPHA:261211)
- Proximal placement of thumb (HP:0009623): Proximal mislocalization of the thumb. Evidence: TAS. Frequency: Occasional (HP:0040283). (ORPHA:261211)
- Sleep apnea (HP:0010535): An intermittent cessation of airflow at the mouth and nose during sleep is known as sleep apnea. Apneas that last at least 10 seconds are considered significant, but individuals with sleep apnea may experience apneas lasting from 20 seconds up to 2 or 3 minutes. Patients may have up to 15 events per hour of sleep. Evidence: TAS. Frequency: Occasional (HP:0040283). (ORPHA:261211)
- Arrhythmia (HP:0011675): Any cardiac rhythm other than the normal sinus rhythm. Such a rhythm may be either of sinus or ectopic origin and either regular or irregular. An arrhythmia may be due to a disturbance in impulse formation or conduction or both. Evidence: TAS. Frequency: Occasional (HP:0040283). (ORPHA:261211)
- Feeding difficulties (HP:0011968): Impaired ability to eat related to problems gathering food and getting ready to suck, chew, or swallow it. Evidence: TAS. Frequency: Very frequent (HP:0040281). (ORPHA:261211)
- Flat face (HP:0012368): Absence of concavity or convexity of the face when viewed in profile. Evidence: TAS. Frequency: Frequent (HP:0040282). (ORPHA:261211)
- Tics (HP:0100033): Repeated, individually recognizable, intermittent movements or movement fragments that are almost always briefly suppressible and are usually associated with awareness of an urge to perform the movement. Evidence: TAS. Frequency: Occasional (HP:0040283). (ORPHA:261211)
- Camptodactyly of finger (HP:0100490): The distal interphalangeal joint and/or the proximal interphalangeal joint of the fingers cannot be extended to 180 degrees by either active or passive extension. Evidence: TAS. Frequency: Frequent (HP:0040282). (ORPHA:261211)